- Polyhydramnios (HP:0001561): The presence of excess amniotic fluid in the uterus during pregnancy. Evidence: TAS. Frequency: Very frequent (HP:0040281). (ORPHA:3405)
- Anemia (HP:0001903): A reduction in erythrocytes volume or hemoglobin concentration. Evidence: TAS. Frequency: Very frequent (HP:0040281). (ORPHA:3405)
- Duodenal atresia (HP:0002247): A developmental defect resulting in complete obliteration of the duodenal lumen, that is, an abnormal closure of the duodenum. Evidence: TAS. Frequency: Very frequent (HP:0040281). (ORPHA:3405)
- Single umbilical artery (HP:0001195): Single umbilical artery (SUA) is the absence of one of the two umbilical arteries surrounding the fetal bladder and in the fetal umbilical cord. Evidence: TAS. Frequency: Frequent (HP:0040282). (ORPHA:3405)
- Ventricular septal defect (HP:0001629): A hole between the two bottom chambers (ventricles) of the heart. The defect is centered around the most superior aspect of the ventricular septum. Evidence: TAS. Frequency: Frequent (HP:0040282). (ORPHA:3405)
- Abnormal aortic morphology (HP:0001679): An abnormality of the aorta. Evidence: TAS. Frequency: Frequent (HP:0040282). (ORPHA:3405)
- Abnormal tricuspid valve morphology (HP:0001702): Any structural anomaly of the tricuspid valve. Evidence: TAS. Frequency: Frequent (HP:0040282). (ORPHA:3405)
- Intestinal atresia (HP:0011100): An abnormal closure, or atresia of the tubular structure of the intestine. Evidence: TAS. Frequency: Frequent (HP:0040282). (ORPHA:3405)
- Hydrops fetalis (HP:0001789): The abnormal accumulation of fluid in two or more fetal compartments, including ascites, pleural effusion, pericardial effusion, and skin edema. Evidence: TAS. Frequency: Occasional (HP:0040283). (ORPHA:3405)
These phenotypes are associated with the disease Umbilical cord ulceration-intestinal atresia syndrome (ORPHA:3405).